- Congenital onset (HP:0003577): A phenotypic abnormality that is present at birth. Evidence: PCS. (PMID:18672102)
- Ventricular septal defect (HP:0001629): A hole between the two bottom chambers (ventricles) of the heart. The defect is centered around the most superior aspect of the ventricular septum. Evidence: PCS. Frequency: 9/12. (PMID:18672102)
- Tetralogy of Fallot (HP:0001636): A congenital cardiac malformation comprising pulmonary stenosis, overriding aorta, ventricular septum defect, and right ventricular hypertrophy. The diagnosis of TOF is made if at least three of the four above mentioned features are present. Evidence: PCS. Frequency: 1/12. (PMID:18672102)
- Atrioventricular canal defect (HP:0006695): A defect of the atrioventricular septum of the heart. Evidence: PCS. Frequency: 1/12. (PMID:18672102)
- Atrial septal defect (HP:0001631): Atrial septal defect (ASD) is a congenital abnormality of the interatrial septum that enables blood flow between the left and right atria via the interatrial septum. Evidence: TAS. Frequency: Occasional (HP:0040283). (OMIM:614429)
- Pulmonic stenosis (HP:0001642): A narrowing of the right ventricular outflow tract that can occur at the pulmonary valve (valvular stenosis), below the pulmonary valve (infundibular stenosis), or above the pulmonary valve (supravalvar stenosis). Evidence: TAS. Frequency: Occasional (HP:0040283). (OMIM:614429)
- Autosomal dominant inheritance (HP:0000006): A mode of inheritance that is observed for traits related to a gene encoded on one of the autosomes (i.e., the human chromosomes 1-22) in which a trait manifests in heterozygotes. In the context of medical genetics, an autosomal dominant disorder is caused when a single copy of the mutant allele is present. Males and females are affected equally, and can both transmit the disorder with a risk of 50% for each child of inheriting the mutant allele. Evidence: PCS. (PMID:18672102)
These phenotypes are associated with the disease ventricular septal defect 1 (OMIM:614429).